- Micrognathia (HP:0000347): Developmental hypoplasia of the mandible. Evidence: TAS. Frequency: Frequent (HP:0040282). (ORPHA:140941)
- Delayed puberty (HP:0000823): Passing the age when puberty normally occurs with no physical or hormonal signs of the onset of puberty. Evidence: TAS. Frequency: Very frequent (HP:0040281). (ORPHA:140941)
- Delayed skeletal maturation (HP:0002750): A decreased rate of skeletal maturation. Delayed skeletal maturation can be diagnosed on the basis of an estimation of the bone age from radiographs of specific bones in the human body. Evidence: TAS. Frequency: Very frequent (HP:0040281). (ORPHA:140941)
- Insulin resistance (HP:0000855): Increased resistance towards insulin, that is, diminished effectiveness of insulin in reducing blood glucose levels. Evidence: TAS. Frequency: Frequent (HP:0040282). (ORPHA:140941)
- Growth delay (HP:0001510): A deficiency or slowing down of growth pre- and postnatally. Evidence: TAS. Frequency: Very frequent (HP:0040281). (ORPHA:140941)
- Truncal obesity (HP:0001956): Obesity located preferentially in the trunk of the body as opposed to the extremities. Evidence: TAS. Frequency: Frequent (HP:0040282). (ORPHA:140941)
- Decreased circulating insulin-like growth factor 1 concentration (HP:0030353): The concentration of insulin-like growth factor 1 (IGF1) in the blood circulation is below the lower limit of normal. Evidence: TAS. Frequency: Very frequent (HP:0040281). (ORPHA:140941)
These phenotypes are associated with the disease Short stature due to primary acid-labile subunit deficiency (ORPHA:140941).